- Facial grimacing (HP:0000273, a Human Phenotype Ontology term). Evidence: TAS. Frequency: Frequent (HP:0040282, a Human Phenotype Ontology term). (ORPHA:648919)
- Agitation (HP:0000713, a Human Phenotype Ontology term): A state of excessive motor activity that is associated with mental distress or a feeling of substantial unease or inner tension. Distinguished from restlessness by the increased level of emotional distress and negative intensity of the experience. Agitation has a significant level of physical activity that is typically threatening to the self or others. Evidence: TAS. Frequency: Frequent (HP:0040282, a Human Phenotype Ontology term). (ORPHA:648919)
- Motor stereotypy (HP:0000733, a Human Phenotype Ontology term): Use of the same abnormal action in response to certain triggers or at random. They may be used as a way to regulate one's internal state but must otherwise have no apparent functional purpose. Evidence: TAS. Frequency: Frequent (HP:0040282, a Human Phenotype Ontology term). (ORPHA:648919)
- Coma (HP:0001259, a Human Phenotype Ontology term): The complete absence of wakefulness and consciousness, which is evident through a lack of response to any form of external stimuli. Evidence: TAS. Frequency: Frequent (HP:0040282, a Human Phenotype Ontology term). (ORPHA:648919)
- Anorexia (HP:0002039, a Human Phenotype Ontology term): Lack of desire to eat (loss of appetite). Evidence: TAS. Frequency: Frequent (HP:0040282, a Human Phenotype Ontology term). (ORPHA:648919)
- Mutism (HP:0002300, a Human Phenotype Ontology term): Complete lack of speech or verbal communication in a person despite attempts to engage in conversation. Mutism as a phenomena assumes the individual has previous capacity for speech and in the pediatric population it assumes that the person is past the age of typical language development. Evidence: TAS. Frequency: Frequent (HP:0040282, a Human Phenotype Ontology term). (ORPHA:648919)
- Abnormal posturing (HP:0002533, a Human Phenotype Ontology term): Involuntary flexion or extension of the arms and legs. Evidence: TAS. Frequency: Frequent (HP:0040282, a Human Phenotype Ontology term). (ORPHA:648919)
- Bipolar affective disorder (HP:0007302, a Human Phenotype Ontology term): Bipolar disorder is an illness of mood characterized by alternating episodes of elevated and depressed moods, which are interspersed with euthymic periods. Evidence: TAS. Frequency: Frequent (HP:0040282, a Human Phenotype Ontology term). (ORPHA:648919)
- Echolalia (HP:0010529, a Human Phenotype Ontology term): Echolalia is the automatic imitative repetition of sounds, words, or phrases in the absence of explicit awareness. The repeated words or phrases are typically odd or used in a non-social manner. These can be words or phrases that the affected individual has heard or invented. Evidence: TAS. Frequency: Frequent (HP:0040282, a Human Phenotype Ontology term). (ORPHA:648919)
- Schizophrenia (HP:0100753, a Human Phenotype Ontology term): A mental disorder characterized by a disintegration of thought processes and emotional responsiveness. It most commonly manifests as auditory hallucinations, paranoid or bizarre delusions, or disorganized speech and thinking. It is accompanied by significant social or occupational dysfunction. The onset of symptoms typically occurs in young adulthood, with a global lifetime prevalence of about 1%. This term is not a helpful parent term to describe abnormal experiences. Evidence: TAS. Frequency: Frequent (HP:0040282, a Human Phenotype Ontology term). (ORPHA:648919)
- Negativism (HP:0410291, a Human Phenotype Ontology term): Opposing or not responding to instructions or external stimuli. Evidence: TAS. Frequency: Frequent (HP:0040282, a Human Phenotype Ontology term). (ORPHA:648919)
- Hyperactivity (HP:0000752, a Human Phenotype Ontology term): Hyperactivity is a condition characterized by constant and unusually high levels of activity, even in situations where it is deemed inappropriate. Evidence: TAS. Frequency: Occasional (HP:0040283, a Human Phenotype Ontology term). (ORPHA:648919)
- Cogwheel rigidity (HP:0002396, a Human Phenotype Ontology term): A type of rigidity in which a muscle responds with cogwheellike jerks to the use of constant force in bending the limb (i.e., it gives way in little, repeated jerks when the muscle is passively stretched). Evidence: TAS. Frequency: Occasional (HP:0040283, a Human Phenotype Ontology term). (ORPHA:648919)
- Staring gaze (HP:0025401, a Human Phenotype Ontology term): An abnormality in which the eyes are held permanently wide open. Evidence: TAS. Frequency: Occasional (HP:0040283, a Human Phenotype Ontology term). (ORPHA:648919)
- Grasp reflex (HP:0030903, a Human Phenotype Ontology term): A type of primitive reflex that can be elicated when the hand of the examiner is gently inserted into the palm of the patient's hand. The palmar surface is stroked or simply touched. The flexor surfaces of the fingers may be stimulated also by the examiner's fingers. The stimulus should be in a distal direction. With a positive response, the patient grasps the examiner's hand with variable strength and continues to grasp as the examiner's hand is moved. Ability to release the grip voluntarily depends on the activity of the reflex; some patients can do so readily, while others can even be lifted off the bed, since the grasp has such power [NCBI Books:NBK395]. Evidence: TAS. Frequency: Occasional (HP:0040283, a Human Phenotype Ontology term). (ORPHA:648919)
- Impulsivity (HP:0100710, a Human Phenotype Ontology term): Acting on the spur of the moment or on a momentary basis without consideration of outcomes; having difficulty establishing or following plans; experiencing a sense of urgency and engaging in behavior that is uninhibited, cannot be inhibited, and is uncontrolled. The possibility of repression is inconceivable. Evidence: TAS. Frequency: Occasional (HP:0040283, a Human Phenotype Ontology term). (ORPHA:648919)
These phenotypes are associated with the disease Idiopathic catatonia (ORPHA:648919, an Orphanet rare-disease identifier).